Phenotypes associated with the disease blepharospasm, benign essential, susceptibility to (OMIM:606798):
- Middle age onset (HP:0003596): A type of adult onset with onset of symptoms at the age of 40 to 60 years. Evidence: TAS. (OMIM:606798)
- Sporadic (HP:0003745): Cases of the disease in question occur without a previous family history, i.e., as isolated cases without being transmitted from a parent and without other siblings being affected. Evidence: TAS. (OMIM:606798)
- Autosomal dominant inheritance (HP:0000006): A mode of inheritance that is observed for traits related to a gene encoded on one of the autosomes (i.e., the human chromosomes 1-22) in which a trait manifests in heterozygotes. In the context of medical genetics, an autosomal dominant disorder is caused when a single copy of the mutant allele is present. Males and females are affected equally, and can both transmit the disorder with a risk of 50% for each child of inheriting the mutant allele. Evidence: IEA. (OMIM:606798)
- Blepharospasm (HP:0000643): A focal dystonia that affects the muscles of the eyelids and brow, associated with involuntary recurrent spasm of both eyelids. Evidence: TAS. (OMIM:606798)